- Autosomal dominant inheritance (HP:0000006): A mode of inheritance that is observed for traits related to a gene encoded on one of the autosomes (i.e., the human chromosomes 1-22) in which a trait manifests in heterozygotes. In the context of medical genetics, an autosomal dominant disorder is caused when a single copy of the mutant allele is present. Males and females are affected equally, and can both transmit the disorder with a risk of 50% for each child of inheriting the mutant allele. Evidence: IEA. (OMIM:126840)
- Duodenal ulcer (HP:0002588): An erosion of the mucous membrane in a portion of the duodenum. Evidence: IEA. (OMIM:126840)
- Hyperpepsinogenemia I (HP:0003238): The concentration of pepsinogen I in the blood circulation is above the upper limit of normal. Evidence: IEA. (OMIM:126840)
- Hypergastrinemia (HP:0500167): An elevated amount of gastrin in the blood. Evidence: TAS. (OMIM:126840)
These phenotypes are associated with the disease duodenal ulcer due to antral G-cell hyperfunction (OMIM:126840).